Phenotypes associated with the disease Dermoodontodysplasia (ORPHA:1660):
- Mandibular prognathia (HP:0000303): Abnormal prominence of the chin related to increased length of the mandible. Evidence: TAS. Frequency: Frequent (HP:0040282). (ORPHA:1660)
- Abnormal eyelid morphology (HP:0000492): An abnormality of the eyelids. Evidence: TAS. Frequency: Frequent (HP:0040282). (ORPHA:1660)
- Ptosis (HP:0000508): The upper eyelid margin is positioned 3 mm or more lower than usual and covers the superior portion of the iris (objective); or, the upper lid margin obscures at least part of the pupil (subjective). Evidence: TAS. Frequency: Frequent (HP:0040282). (ORPHA:1660)
- Microdontia (HP:0000691): Decreased size of the teeth, which can be defined as a mesiodistal tooth diameter (width) more than 2 SD below mean. Alternatively, an apparently decreased maximum width of tooth. Evidence: TAS. Frequency: Very frequent (HP:0040281). (ORPHA:1660)
- Dry skin (HP:0000958): Skin characterized by the lack of natural or normal moisture. Evidence: TAS. Frequency: Frequent (HP:0040282). (ORPHA:1660)
- Thin skin (HP:0000963): Reduction in thickness of the skin, generally associated with a loss of suppleness and elasticity of the skin. Evidence: TAS. Frequency: Very frequent (HP:0040281). (ORPHA:1660)
- Hypohidrosis (HP:0000966): Abnormally diminished capacity to sweat. Evidence: TAS. Frequency: Frequent (HP:0040282). (ORPHA:1660)
- Ectodermal dysplasia (HP:0000968): Ectodermal dysplasia is a group of conditions in which there is abnormal development of the skin, hair, nails, teeth, or sweat glands. Evidence: TAS. Frequency: Very frequent (HP:0040281). (ORPHA:1660)
- Melanocytic nevus (HP:0000995): A oval and round, colored (usually medium-to dark brown, reddish brown, or flesh colored) lesion. Typically, a melanocytic nevus is less than 6 mm in diameter, but may be much smaller or larger. Evidence: TAS. Frequency: Frequent (HP:0040282). (ORPHA:1660)
- Sparse scalp hair (HP:0002209): Decreased number of hairs per unit area of skin of the scalp. Evidence: TAS. Frequency: Very frequent (HP:0040281). (ORPHA:1660)
- Sparse body hair (HP:0002231): Sparseness of the body hair. Evidence: TAS. Frequency: Very frequent (HP:0040281). (ORPHA:1660)
- Trichodysplasia (HP:0002552): Developmental dysplasia of the hair. Evidence: TAS. Frequency: Very frequent (HP:0040281). (ORPHA:1660)
- Abnormal dermatoglyphics (HP:0007477): An abnormality of dermatoglyphs (fingerprints), which are present on fingers, palms, toes, and soles. Evidence: TAS. Frequency: Frequent (HP:0040282). (ORPHA:1660)
- Tooth agenesis (HP:0009804): The absence of one or more teeth from the normal series by a failure to develop. Evidence: TAS. Frequency: Very frequent (HP:0040281). (ORPHA:1660)
- Toenail dysplasia (HP:0100797): An abnormality of the development of the toenails. Evidence: TAS. Frequency: Very frequent (HP:0040281). (ORPHA:1660)
- Fingernail dysplasia (HP:0100798): An abnormality of the development of the fingernails. Evidence: TAS. Frequency: Very frequent (HP:0040281). (ORPHA:1660)